- Facial asymmetry (HP:0000324): An abnormal difference between the left and right sides of the face. Evidence: TAS. Frequency: Occasional (HP:0040283). (ORPHA:1310)
- Proptosis (HP:0000520): An eye that is protruding anterior to the plane of the face to a greater extent than is typical. Evidence: TAS. Frequency: Occasional (HP:0040283). (ORPHA:1310)
- Atypical behavior (HP:0000708): Atypical behavior is an abnormality in a person's actions that can be controlled or modulated by the will of the individual. While abnormal behaviors can be difficult to control, they are distinct from other abnormal actions that cannot be affected by the individual's will. Evidence: TAS. Frequency: Frequent (HP:0040282). (ORPHA:1310)
- Fever (HP:0001945): Body temperature elevated above the normal range. Evidence: TAS. Frequency: Frequent (HP:0040282). (ORPHA:1310)
- Respiratory insufficiency (HP:0002093). Evidence: TAS. Frequency: Occasional (HP:0040283). (ORPHA:1310)
- Scoliosis (HP:0002650): The presence of an abnormal lateral curvature of the spine. Evidence: TAS. Frequency: Occasional (HP:0040283). (ORPHA:1310)
- Calvarial hyperostosis (HP:0004490): Excessive growth of the calvaria. Evidence: TAS. Frequency: Occasional (HP:0040283). (ORPHA:1310)
- Cortical irregularity (HP:0005731): An abnormal irregularity of cortical bone. Evidence: TAS. Frequency: Very frequent (HP:0040281). (ORPHA:1310)
- Cortical thickening of long bone diaphyses (HP:0005791): Abnormal thickening of the cortex of the diaphyseal region of long bones. Evidence: TAS. Frequency: Occasional (HP:0040283). (ORPHA:1310)
- Periosteal thickening of long tubular bones (HP:0006465): Thickening of the periosteum of long bone. Evidence: TAS. Frequency: Frequent (HP:0040282). (ORPHA:1310)
- Feeding difficulties in infancy (HP:0008872): Impaired feeding performance of an infant as manifested by difficulties such as weak and ineffective sucking, brief bursts of sucking, and falling asleep during sucking. There may be difficulties with chewing or maintaining attention. Evidence: TAS. Frequency: Occasional (HP:0040283). (ORPHA:1310)
- Increased circulating immunoglobulin concentration (HP:0010702): An increased level of gamma globulin (immunoglobulin) in the blood. Evidence: TAS. Frequency: Occasional (HP:0040283). (ORPHA:1310)
- Cellulitis (HP:0100658): A bacterial infection and inflammation of the skin und subcutaneous tissues. Evidence: TAS. Frequency: Very frequent (HP:0040281). (ORPHA:1310)
- Hyperesthesia (HP:0100963): Increased sensitivity to stimulation, excluding the special senses, which may refer to various modes of cutaneous sensibility including touch and thermal sensation without pain, as well as to pain. Evidence: TAS. Frequency: Frequent (HP:0040282). (ORPHA:1310)
These phenotypes are associated with the disease Caffey disease (ORPHA:1310).